Phenotypes associated with the disease Schizencephaly (ORPHA:799):
- Strabismus (HP:0000486): A misalignment of the eyes so that the visual axes deviate from bifoveal fixation. The classification of strabismus may be based on a number of features including the relative position of the eyes, whether the deviation is latent or manifest, intermittent or constant, concomitant or otherwise and according to the age of onset and the relevance of any associated refractive error. Evidence: TAS. Frequency: Very frequent (HP:0040281). (ORPHA:799)
- Intellectual disability (HP:0001249): The term intellectual disability or intellectual developmental disorder is used to describe significantly sub-average intellectual and adaptive functioning based on clinical assessment and as measured by individually administered, appropriately normed, standardized and validated tests of intellectual functioning and adaptive behavior, with onset during the developmental period from infancy through adolescence. Evidence: TAS. Frequency: Frequent (HP:0040282). (ORPHA:799)
- Seizure (HP:0001250): A seizure is an intermittent abnormality of nervous system physiology characterized by a transient occurrence of signs and/or symptoms due to abnormal excessive or synchronous neuronal activity in the brain. Evidence: TAS. Frequency: Frequent (HP:0040282). (ORPHA:799)
- Spasticity (HP:0001257): A motor disorder characterized by a velocity-dependent increase in tonic stretch reflexes with increased muscle tone, exaggerated (hyperexcitable) tendon reflexes. Evidence: TAS. Frequency: Very frequent (HP:0040281). (ORPHA:799)
- Global developmental delay (HP:0001263): A delay in the achievement of motor or mental milestones in the domains of development of a child, including motor skills, speech and language, cognitive skills, and social and emotional skills. This term should only be used to describe children younger than five years of age. Evidence: TAS. Frequency: Frequent (HP:0040282). (ORPHA:799)
- Hemiparesis (HP:0001269): Loss of strength in the arm, leg, and sometimes face on one side of the body. Hemiplegia refers to a complete loss of strength, whereas hemiparesis refers to an incomplete loss of strength. Evidence: TAS. Frequency: Frequent (HP:0040282). (ORPHA:799)
- Porencephalic cyst (HP:0002132): A cavity within the cerebral hemisphere, filled with cerebrospinal fluid, that communicates directly with the ventricular system. Evidence: TAS. Frequency: Very frequent (HP:0040281). (ORPHA:799)
- EEG abnormality (HP:0002353): Abnormality observed by electroencephalogram (EEG), which is used to record of the brain's spontaneous electrical activity from multiple electrodes placed on the scalp. Evidence: TAS. Frequency: Very frequent (HP:0040281). (ORPHA:799)
- Spastic tetraplegia (HP:0002510): Spastic paralysis affecting all four limbs. Evidence: TAS. Frequency: Frequent (HP:0040282). (ORPHA:799)
- Aplasia/Hypoplasia of the corpus callosum (HP:0007370): Absence or underdevelopment of the corpus callosum. Evidence: TAS. Frequency: Very frequent (HP:0040281). (ORPHA:799)